- Constriction of peripheral visual field (HP:0001133): An absolute or relative decrease in retinal sensitivity extending from edge (periphery) of the visual field in a concentric pattern. The visual field is the area that is perceived simultaneously by a fixating eye. Evidence: PCS. (PMID:20939871)
- Spicular pigmentation of the retina (HP:0007737): Pigment migration into the retina in a bone-spicule configuration (resembling the nucleated cells within the lacuna of bone). Evidence: PCS. (PMID:17325180)
- Nyctalopia (HP:0000662): Inability to see well at night or in poor light. Evidence: PCS. Frequency: 5/6. (PMID:20939871)
- Perifoveal ring of hyperautofluorescence (HP:0030629). Evidence: PCS. Frequency: 4/6. (PMID:20939871)
- Macular edema (HP:0040049): Thickening of the retina that takes place due to accumulation of extracellular fluid in the macula as a nonspecific response to blood-retinal barrier breakdown. It can either have a cystoid aspect in the fovea, or a more diffuse aspect. Evidence: PCS. Frequency: 4/6. (PMID:17325180)
- Macular degeneration (HP:0000608): A nonspecific term denoting degeneration of the retinal pigment epithelium and/or retinal photoreceptor cells of the macula lutea. Evidence: TAS. Frequency: Occasional (HP:0040283). (OMIM:600138)
- Typified by incomplete penetrance (HP:0003829): Description of conditions in which not all individuals with a given genotype exhibit the disease. Penetrance is the proportion that develop disease given a lifespan of 80 years. Evidence: PCS. (PMID:23041261)
- Blindness (HP:0000618): Blindness is the condition of lacking visual perception defined as a profound reduction in visual perception. On the 6m visual acuity scale, blindness is defined as less than 3/60. On the 20ft visual acuity scale, blindness is defined as less than 20/400. On the decimal visual acuity scale, blindness is defined as less than 0.05. Blindness is typically characterized by a visual field of no greater than 10 degrees in radius around central fixation. Evidence: TAS. (OMIM:600138)
- Reduced visual acuity (HP:0007663). Evidence: PCS. (PMID:20939871)
- Macular atrophy (HP:0007401): A nonspecific term denoting wasting, especially as a result of degeneration, of the retinal pigment epithelium (RPE) and neurosensory retinal cells in the macula. Evidence: TAS. Frequency: Occasional (HP:0040283). (OMIM:600138)
- Rod-cone dystrophy (HP:0000510): An inherited retinal disease subtype in which the rod photoreceptors appear to be more severely affected than the cone photoreceptors. Typical presentation is with nyctalopia (due to rod dysfunction) followed by loss of mid-peripheral field of vision, which gradually extends and leaves many patients with a small central island of vision due to the preservation of macular cones. Evidence: PCS. (PMID:20939871)
- Optic disc pallor (HP:0000543): A pale yellow discoloration of the optic disc (the area of the optic nerve head in the retina). The optic disc normally has a pinkish hue with a central yellowish depression. Evidence: PCS. Frequency: 2/6. (PMID:20939871)
- Autosomal dominant inheritance (HP:0000006): A mode of inheritance that is observed for traits related to a gene encoded on one of the autosomes (i.e., the human chromosomes 1-22) in which a trait manifests in heterozygotes. In the context of medical genetics, an autosomal dominant disorder is caused when a single copy of the mutant allele is present. Males and females are affected equally, and can both transmit the disorder with a risk of 50% for each child of inheriting the mutant allele. Evidence: PCS. (PMID:17325180)
These phenotypes are associated with the disease retinitis pigmentosa 11 (OMIM:600138).